- Abnormality of the middle ear ossicles (HP:0004452): An abnormality of the middle-ear ossicles (three small bones called malleus, incus, and stapes) that are contained within the middle ear and serve to transmit sounds from the air to the fluid-filled labyrinth (cochlea). Evidence: TAS. (OMIM:221300)
- Autosomal recessive inheritance (HP:0000007): A mode of inheritance that is observed for traits related to a gene encoded on one of the autosomes (i.e., the human chromosomes 1-22) in which a trait manifests in individuals with two pathogenic alleles, either homozygotes (two copies of the same mutant allele) or compound heterozygotes (whereby each copy of a gene has a distinct mutant allele). Evidence: TAS. (OMIM:221300)
- Conductive hearing impairment (HP:0000405): An abnormality of vibrational conductance of sound to the inner ear leading to impairment of sensory perception of sound. Evidence: TAS. (OMIM:221300)
- Hypogonadism (HP:0000135): A decreased functionality of the gonad. Evidence: TAS. (OMIM:221300)
- Abnormal pinna morphology (HP:0000377): An abnormality of the pinna, which is also referred to as the auricle or external ear. Evidence: TAS. (OMIM:221300)
- Low-set ears (HP:0000369): Upper insertion of the ear to the scalp below an imaginary horizontal line drawn between the inner canthi of the eye and extending posteriorly to the ear. Evidence: TAS. (OMIM:221300)
- Intellectual disability (HP:0001249): The term intellectual disability or intellectual developmental disorder is used to describe significantly sub-average intellectual and adaptive functioning based on clinical assessment and as measured by individually administered, appropriately normed, standardized and validated tests of intellectual functioning and adaptive behavior, with onset during the developmental period from infancy through adolescence. Evidence: TAS. (OMIM:221300)
These phenotypes are associated with the disease conductive deafness-malformed external ear syndrome (OMIM:221300).